- Narrow mouth (HP:0000160): Distance between the commissures of the mouth more than 2 SD below the mean. Alternatively, an apparently decreased width of the oral aperture (subjective). Evidence: TAS. Frequency: Frequent (HP:0040282). (ORPHA:969)
- Thick lower lip vermilion (HP:0000179): Increased thickness of the lower lip, leading to a prominent appearance of the lower lip. The height of the vermilion of the lower lip in the midline is more than 2 SD above the mean. Alternatively, an apparently increased height of the vermilion of the lower lip in the frontal view (subjective). Evidence: TAS. Frequency: Frequent (HP:0040282). (ORPHA:969)
- Round face (HP:0000311): The facial appearance is more circular than usual as viewed from the front. Evidence: TAS. Frequency: Very frequent (HP:0040281). (ORPHA:969)
- Long philtrum (HP:0000343): Distance between nasal base and midline upper lip vermilion border more than 2 SD above the mean. Alternatively, an apparently increased distance between nasal base and midline upper lip vermilion border. Evidence: TAS. Frequency: Very frequent (HP:0040281). (ORPHA:969)
- Bulbous nose (HP:0000414): Increased volume and globular shape of the anteroinferior aspect of the nose. Evidence: TAS. Frequency: Frequent (HP:0040282). (ORPHA:969)
- Anteverted nares (HP:0000463): Anteriorly-facing nostrils viewed with the head in the Frankfurt horizontal and the eyes of the observer level with the eyes of the subject. This gives the appearance of an upturned nose (upturned nasal tip). Evidence: TAS. Frequency: Very frequent (HP:0040281). (ORPHA:969)
- Long eyelashes (HP:0000527): Mid upper eyelash length >10 mm or increased length of the eyelashes (subjective). Evidence: TAS. Frequency: Very frequent (HP:0040281). (ORPHA:969)
- Abnormal eyebrow morphology (HP:0000534): An abnormality of the eyebrow. Evidence: TAS. Frequency: Very frequent (HP:0040281). (ORPHA:969)
- Decreased nerve conduction velocity (HP:0000762): A reduction in the speed at which electrical signals propagate along the axon of a neuron. Evidence: TAS. Frequency: Frequent (HP:0040282). (ORPHA:969)
- Brachydactyly (HP:0001156): Digits that appear disproportionately short compared to the hand/foot. The word brachydactyly is used here to describe a series distinct patterns of shortened digits (brachydactyly types A-E). This is the sense used here. Evidence: TAS. Frequency: Very frequent (HP:0040281). (ORPHA:969)
- Joint stiffness (HP:0001387): Joint stiffness is a perceived sensation of tightness in a joint or joints when attempting to move them after a period of inactivity. Joint stiffness typically subsides over time. Evidence: TAS. Frequency: Occasional (HP:0040283). (ORPHA:969)
- Hoarse voice (HP:0001609): Hoarseness refers to a change in the pitch or quality of the voice, with the voice sounding weak, very breathy, scratchy, or husky. Evidence: TAS. Frequency: Occasional (HP:0040283). (ORPHA:969)
- Delayed skeletal maturation (HP:0002750): A decreased rate of skeletal maturation. Delayed skeletal maturation can be diagnosed on the basis of an estimation of the bone age from radiographs of specific bones in the human body. Evidence: TAS. Frequency: Occasional (HP:0040283). (ORPHA:969)
- Abnormal femur morphology (HP:0002823): Any anomaly of the structure of the femur. Evidence: TAS. Frequency: Occasional (HP:0040283). (ORPHA:969)
- Short nose (HP:0003196): Distance from nasion to subnasale more than two standard deviations below the mean, or alternatively, an apparently decreased length from the nasal root to the nasal tip. Evidence: TAS. Frequency: Very frequent (HP:0040281). (ORPHA:969)
- Ovoid vertebral bodies (HP:0003300): When viewed in lateral radiographs, vertebral bodies have a roughly rectangular configuration. This term applies if the vertebral body appears rounded or oval. Evidence: TAS. Frequency: Occasional (HP:0040283). (ORPHA:969)
- Severe short stature (HP:0003510): A severe degree of short stature, more than -4 SD from the mean corrected for age and sex. Evidence: TAS. Frequency: Very frequent (HP:0040281). (ORPHA:969)
- Short palm (HP:0004279): Short palm. Evidence: TAS. Frequency: Very frequent (HP:0040281). (ORPHA:969)
- Fifth metacarpal with ulnar notch (HP:0005900): Presence of an angular or V -shaped indentation on the ulnar side of the fifth metacarpal bone (i.e., on the sides towards the fifth finger). Evidence: TAS. Frequency: Occasional (HP:0040283). (ORPHA:969)
- Abnormal epiphysis morphology (HP:0005930): An anomaly of epiphysis, which is the expanded articular end of a long bone that developes from a secondary ossification center, and which during the period of growth is either entirely cartilaginous or is separated from the shaft by a cartilaginous disk. Evidence: TAS. Frequency: Occasional (HP:0040283). (ORPHA:969)
- Short metacarpal (HP:0010049): Diminished length of one or more metacarpal bones in relation to the others of the same hand or to the contralateral metacarpal. Evidence: TAS. Frequency: Occasional (HP:0040283). (ORPHA:969)
- Small hand (HP:0200055): Disproportionately small hand. Evidence: TAS. Frequency: Very frequent (HP:0040281). (ORPHA:969)
These phenotypes are associated with the disease Acromicric dysplasia (ORPHA:969).